Phenotypes associated with the disease leukemia, acute myelocytic, with polyposis coli and colon cancer (OMIM:246470, an entry in Online Mendelian Inheritance in Man):
- Adenomatous colonic polyposis (HP:0005227, a Human Phenotype Ontology term): Presence of multiple adenomatous polyps in the colon. Evidence: IEA. (OMIM:246470)
- Colon cancer (HP:0003003, a Human Phenotype Ontology term). Evidence: TAS. (OMIM:246470)
- Acute myeloid leukemia (HP:0004808, a Human Phenotype Ontology term): A form of leukemia characterized by overproduction of an early myeloid cell. Evidence: IEA. (OMIM:246470)
- Autosomal recessive inheritance (HP:0000007, a Human Phenotype Ontology term): A mode of inheritance that is observed for traits related to a gene encoded on one of the autosomes (i.e., the human chromosomes 1-22) in which a trait manifests in individuals with two pathogenic alleles, either homozygotes (two copies of the same mutant allele) or compound heterozygotes (whereby each copy of a gene has a distinct mutant allele). Evidence: IEA. (OMIM:246470)
- Abnormality of the genitourinary system (HP:0000119, a Human Phenotype Ontology term): The presence of any abnormality of the genitourinary system. Evidence: IEA. (OMIM:246470)